- Autoimmune hemolytic anemia (HP:0001890): An autoimmune form of hemolytic anemia. Evidence: TAS. Frequency: Very frequent (HP:0040281). (ORPHA:90035)
- Fever (HP:0001945): Body temperature elevated above the normal range. Evidence: TAS. Frequency: Very frequent (HP:0040281). (ORPHA:90035)
- Diarrhea (HP:0002014): Abnormally increased frequency (usually defined as three or more) loose or watery bowel movements a day. Evidence: TAS. Frequency: Occasional (HP:0040283). (ORPHA:90035)
- Nausea and vomiting (HP:0002017): Nausea is a commonly encountered symptom that has been defined as an unpleasant painless subjective feeling that one will imminently vomit. Vomiting has been defined as the forceful expulsion of the contents of the stomach, duodenum, or jejunum through the oral cavity. While nausea and vomiting are often thought to exist on a temporal continuum, this is not always the case. There are situations when severe nausea may be present without emesis and less frequently, when emesis may be present without preceding nausea. Evidence: TAS. Frequency: Occasional (HP:0040283). (ORPHA:90035)
- Recurrent respiratory infections (HP:0002205): An increased susceptibility to respiratory infections as manifested by a history of recurrent respiratory infections. Evidence: TAS. Frequency: Very frequent (HP:0040281). (ORPHA:90035)
- Headache (HP:0002315): Cephalgia, or pain sensed in various parts of the head, not confined to the area of distribution of any nerve. Evidence: TAS. Frequency: Very frequent (HP:0040281). (ORPHA:90035)
- Arthralgia (HP:0002829): Joint pain. Evidence: TAS. Frequency: Very frequent (HP:0040281). (ORPHA:90035)
- Back pain (HP:0003418): An unpleasant sensation characterized by physical discomfort (such as pricking, throbbing, or aching) localized to the back. Evidence: TAS. Frequency: Very frequent (HP:0040281). (ORPHA:90035)
- Hemoglobinuria (HP:0003641): The presence of free hemoglobin in the urine. Evidence: TAS. Frequency: Very frequent (HP:0040281). (ORPHA:90035)
- Coombs-positive hemolytic anemia (HP:0004844): A type of hemolytic anemia in which the Coombs test is positive. Evidence: TAS. Frequency: Very frequent (HP:0040281). (ORPHA:90035)
- Abnormal urinary color (HP:0012086): An abnormal color of the urine, that is, the color of the urine appears different from the usual straw-yellow color. Evidence: TAS. Frequency: Very frequent (HP:0040281). (ORPHA:90035)
These phenotypes are associated with the disease Paroxysmal cold hemoglobinuria (ORPHA:90035).